- Cardiomyopathy (HP:0001638): A myocardial disorder in which the heart muscle is structurally and functionally abnormal, in the absence of coronary artery disease, hypertension, valvular disease and congenital heart disease sufficient to cause the observed myocardial abnormality. Evidence: TAS. Frequency: Frequent (HP:0040282). (ORPHA:3283)
- Arrhythmia (HP:0011675): Any cardiac rhythm other than the normal sinus rhythm. Such a rhythm may be either of sinus or ectopic origin and either regular or irregular. An arrhythmia may be due to a disturbance in impulse formation or conduction or both. Evidence: TAS. Frequency: Very frequent (HP:0040281). (ORPHA:3283)
- Junctional ectopic tachycardia (HP:0011716): Junctional ectopic tachycardia (JET) is a unique type of supraventricular arrhythmia defined by narrow QRS complex and atrioventricular (AV) dissociation or retrograde atrial conduction in a 1:1 pattern. Evidence: TAS. Frequency: Very frequent (HP:0040281). (ORPHA:3283)
- Neoplasm of the heart (HP:0100544): A tumor (abnormal growth of tissue) of the heart. Evidence: TAS. Frequency: Occasional (HP:0040283). (ORPHA:3283)
These phenotypes are associated with the disease His bundle tachycardia (ORPHA:3283).